Phenotypes associated with the disease hairy ears, Y-linked (OMIM:425500):
- Abnormality of the ear (HP:0000598): An abnormality of the ear. Evidence: IEA. (OMIM:425500)